- Nephrotic syndrome (HP:0000100): Nephrotic syndrome is a collection of findings resulting from glomerular dysfunction with an increase in glomerular capillary wall permeability associated with pronounced proteinuria. Nephrotic syndrome refers to the constellation of clinical findings that result from severe renal loss of protein, with Proteinuria and hypoalbuminemia, edema, and hyperlipidemia. Evidence: TAS. Frequency: Very frequent (HP:0040281). (ORPHA:69061)
- Lymphedema (HP:0001004): Localized fluid retention and tissue swelling caused by a compromised lymphatic system. Evidence: TAS. Frequency: Very frequent (HP:0040281). (ORPHA:69061)
These phenotypes are associated with the disease Idiopathic steroid-sensitive nephrotic syndrome (ORPHA:69061).